- Renal hypoplasia (HP:0000089): Hypoplasia of the kidney. Evidence: TAS. Frequency: Very frequent (HP:0040281). (ORPHA:97362)
- Vesicoureteral reflux (HP:0000076): Abnormal (retrograde) movement of urine from the bladder into ureters or kidneys related to inadequacy of the valvular mechanism at the ureterovesicular junction or other causes. Evidence: TAS. Frequency: Frequent (HP:0040282). (ORPHA:97362)
- Proteinuria (HP:0000093): Increased levels of protein in the urine. Evidence: TAS. Frequency: Frequent (HP:0040282). (ORPHA:97362)
- Renal cyst (HP:0000107): A fluid filled sac in the kidney. Evidence: TAS. Frequency: Frequent (HP:0040282). (ORPHA:97362)
- Hypertension (HP:0000822): The presence of chronic increased pressure in the systemic arterial system. Evidence: TAS. Frequency: Frequent (HP:0040282). (ORPHA:97362)
- Oligohydramnios (HP:0001562): Diminished amniotic fluid volume in pregnancy. Evidence: TAS. Frequency: Frequent (HP:0040282). (ORPHA:97362)
- Potter facies (HP:0002009): A facial appearance characteristic of a fetus or neonate due to oligohydramnios experienced in the womb, comprising ocular hypertelorism, low-set ears, receding chin, and flattening of the nose. Evidence: TAS. Frequency: Frequent (HP:0040282). (ORPHA:97362)
- Feeding difficulties (HP:0011968): Impaired ability to eat related to problems gathering food and getting ready to suck, chew, or swallow it. Evidence: TAS. Frequency: Frequent (HP:0040282). (ORPHA:97362)
- Decreased glomerular filtration rate (HP:0012213): An abnormal reduction in the volume of fluid filtered out of plasma through glomerular capillary walls into Bowman's capsules per unit of time. Evidence: TAS. Frequency: Frequent (HP:0040282). (ORPHA:97362)
- Chronic kidney disease (HP:0012622): Functional anomaly of the kidney persisting for at least three months. Evidence: TAS. Frequency: Frequent (HP:0040282). (ORPHA:97362)
- Cryptorchidism (HP:0000028): Testis in inguinal canal. That is, absence of one or both testes from the scrotum owing to failure of the testis or testes to descend through the inguinal canal to the scrotum. Evidence: TAS. Frequency: Occasional (HP:0040283). (ORPHA:97362)
- Astigmatism (HP:0000483): A type of refraction error associated with abnormal curvatures on the anterior and/or posterior surface of the cornea. Evidence: TAS. Frequency: Occasional (HP:0040283). (ORPHA:97362)
- Hypermetropia (HP:0000540): An abnormality of refraction characterized by the ability to see objects in the distance clearly, while objects nearby appear blurry. Evidence: TAS. Frequency: Occasional (HP:0040283). (ORPHA:97362)
- Nystagmus (HP:0000639): Rhythmic, involuntary oscillations of one or both eyes related to abnormality in fixation, conjugate gaze, or vestibular mechanisms. Evidence: TAS. Frequency: Occasional (HP:0040283). (ORPHA:97362)
- Edema (HP:0000969): An abnormal accumulation of fluid beneath the skin, or in one or more cavities of the body. Evidence: TAS. Frequency: Occasional (HP:0040283). (ORPHA:97362)
- Lethargy (HP:0001254): A state of fatigue, either physical or mental slowness and sluggishness, with difficulties in initiating or performing simple tasks. Distinguished from apathy which implies indifference and a lack of desire or interest in the task. A person with lethargy may have the desire, but not the energy to engage in personal or socially relevant tasks. Evidence: TAS. Frequency: Occasional (HP:0040283). (ORPHA:97362)
- Failure to thrive (HP:0001508): Failure to thrive (FTT) refers to a child whose physical growth is substantially below the norm. Evidence: TAS. Frequency: Occasional (HP:0040283). (ORPHA:97362)
- Growth delay (HP:0001510): A deficiency or slowing down of growth pre- and postnatally. Evidence: TAS. Frequency: Occasional (HP:0040283). (ORPHA:97362)
- Small for gestational age (HP:0001518): Smaller than normal size according to sex and gestational age related norms, defined as a weight below the 10th percentile for the gestational age. Evidence: TAS. Frequency: Occasional (HP:0040283). (ORPHA:97362)
- Premature birth (HP:0001622): The birth of a baby of less than 37 weeks of gestational age. Evidence: TAS. Frequency: Occasional (HP:0040283). (ORPHA:97362)
- Anemia (HP:0001903): A reduction in erythrocytes volume or hemoglobin concentration. Evidence: TAS. Frequency: Occasional (HP:0040283). (ORPHA:97362)
- Metabolic acidosis (HP:0001942): Metabolic acidosis (MA) is characterized by a fall in blood pH due to a reduction of serum bicarbonate concentration. This can occur as a result of either the accumulation of acids (high anion gap MA) or the loss of bicarbonate from the gastrointestinal tract or the kidney (hyperchloremic MA). By definition, MA is not due to a respirary cause. Evidence: TAS. Frequency: Occasional (HP:0040283). (ORPHA:97362)
- Hyperkalemia (HP:0002153): The concentration of potassium(1+) in the blood circulation is above the upper limit of normal. Evidence: TAS. Frequency: Occasional (HP:0040283). (ORPHA:97362)
- Neonatal respiratory distress (HP:0002643): Respiratory difficulty as newborn. Evidence: TAS. Frequency: Occasional (HP:0040283). (ORPHA:97362)
- Hyponatremia (HP:0002902): The concentration of sodium in the blood circulation is below the lower limit of normal. Evidence: TAS. Frequency: Occasional (HP:0040283). (ORPHA:97362)
- Microscopic hematuria (HP:0002907): Microscopic hematuria detected by dipstick or microscopic examination of the urine. Evidence: TAS. Frequency: Occasional (HP:0040283). (ORPHA:97362)
- Glycosuria (HP:0003076): An increased concentration of glucose in the urine. Evidence: TAS. Frequency: Occasional (HP:0040283). (ORPHA:97362)
- Short stature (HP:0004322): A height below that which is expected according to age and gender norms. Although there is no universally accepted definition of short stature, many refer to "short stature" as height more than 2 standard deviations below the mean for age and gender (or below the 3rd percentile for age and gender dependent norms). Evidence: TAS. Frequency: Occasional (HP:0040283). (ORPHA:97362)
- Neurodevelopmental delay (HP:0012758): Neurodevelopmental delay (NDD) refers to delays in the maturation of the brain and central nervous system; infants and young children with NDD may experience delays in the development of one or more skills including gross motor abilities, fine-motor coordination, language abilities and ability to solve increasingly complex problems. Evidence: TAS. Frequency: Occasional (HP:0040283). (ORPHA:97362)
- Beta 2-microglobulinuria (HP:0025466): Increased level of beta 2-microglobulins in the urine. Evidence: TAS. Frequency: Occasional (HP:0040283). (ORPHA:97362)
- Oliguria (HP:0100520): Low output of urine, clinically classified as an output below 300-500ml/day. Evidence: TAS. Frequency: Occasional (HP:0040283). (ORPHA:97362)
These phenotypes are associated with the disease Renal hypoplasia, bilateral (ORPHA:97362).